Phenotypes associated with the disease patterned macular dystrophy 3 (OMIM:617111):
- Choroidal neovascularization (HP:0011506): Choroidal neovascularization (CNV) is the inward growth of new blood vessels arising from the choriocapillaris. Depending on the stage of development, they can be external (type 1 NV) or internal (type 2 NV) to the retinal pigment epithelium. Evidence: PCS. Frequency: Very rare (HP:0040284). (PMID:26744326)
- Young adult onset (HP:0011462): Onset of disease at the age of between 16 and 40 years. Evidence: PCS. (PMID:26744326)
- Reduced visual acuity (HP:0007663). Evidence: PCS. (PMID:26744326)
- Macular atrophy (HP:0007401): A nonspecific term denoting wasting, especially as a result of degeneration, of the retinal pigment epithelium (RPE) and neurosensory retinal cells in the macula. Evidence: PCS. (PMID:26744326)
- Rod-cone dystrophy (HP:0000510): An inherited retinal disease subtype in which the rod photoreceptors appear to be more severely affected than the cone photoreceptors. Typical presentation is with nyctalopia (due to rod dysfunction) followed by loss of mid-peripheral field of vision, which gradually extends and leaves many patients with a small central island of vision due to the preservation of macular cones. Evidence: PCS. (PMID:26744326)
- Autosomal dominant inheritance (HP:0000006): A mode of inheritance that is observed for traits related to a gene encoded on one of the autosomes (i.e., the human chromosomes 1-22) in which a trait manifests in heterozygotes. In the context of medical genetics, an autosomal dominant disorder is caused when a single copy of the mutant allele is present. Males and females are affected equally, and can both transmit the disorder with a risk of 50% for each child of inheriting the mutant allele. Evidence: PCS. (PMID:26744326)